Phenotypes associated with the disease Pouchitis (ORPHA:217067):
- Fever (HP:0001945): Body temperature elevated above the normal range. Evidence: TAS. Frequency: Frequent (HP:0040282). (ORPHA:217067)
- Diarrhea (HP:0002014): Abnormally increased frequency (usually defined as three or more) loose or watery bowel movements a day. Evidence: TAS. Frequency: Frequent (HP:0040282). (ORPHA:217067)
- Abdominal pain (HP:0002027): An unpleasant sensation characterized by physical discomfort (such as pricking, throbbing, or aching) and perceived to originate in the abdomen. Evidence: TAS. Frequency: Frequent (HP:0040282). (ORPHA:217067)
- Hematochezia (HP:0002573): The passage of fresh (red) blood per anus, usually in or with stools. Most rectal bleeding comes from the colon, rectum, or anus. Evidence: TAS. Frequency: Frequent (HP:0040282). (ORPHA:217067)
- Bowel incontinence (HP:0002607): Involuntary fecal soiling in adults and children who have usually already been toilet trained. Evidence: TAS. Frequency: Frequent (HP:0040282). (ORPHA:217067)
- Bowel urgency (HP:0012701): A sudden, irresistible need to have a bowel movement. Evidence: TAS. Frequency: Frequent (HP:0040282). (ORPHA:217067)
- Tenesmus (HP:0012702): A repeated, painful urge to defecate without excreting stool. Evidence: TAS. Frequency: Frequent (HP:0040282). (ORPHA:217067)
- Abdominal cramps (HP:0032155): A type of abdominal pain characterized by a feeling of contractions and typically fluctuating in intensity. Evidence: TAS. Frequency: Frequent (HP:0040282). (ORPHA:217067)
- Clostridium difficile colitis (HP:0032168): An infection of the colon (colitis) by clostridium difficile. Evidence: TAS. Frequency: Frequent (HP:0040282). (ORPHA:217067)
- Anal pain (HP:0500005): Pain in and around the anus or rectum (perianal region). Evidence: TAS. Frequency: Frequent (HP:0040282). (ORPHA:217067)